Phenotypes associated with the disease Dystonia 28 (ORPHA:589618):
- Generalized dystonia (HP:0007325): A type of dystonia that affects all or most of the body. Evidence: TAS. Frequency: Very frequent (HP:0040281). (ORPHA:589618)
- Globus pallidus hypointensity on susceptibility-weighted imaging (HP:0033049): Hypointence (dark) appearance of the globus pallidus inmagnetic resonance imaging using susceptibility weighted imaging (SWI). Evidence: TAS. Frequency: Very frequent (HP:0040281). (ORPHA:589618)
- Microcephaly (HP:0000252): Head circumference below 2 standard deviations below the mean for age and gender. Evidence: TAS. Frequency: Frequent (HP:0040282). (ORPHA:589618)
- Torticollis (HP:0000473): Involuntary contractions of the neck musculature resulting in an abnormal posture of or abnormal movements of the head. Evidence: TAS. Frequency: Frequent (HP:0040282). (ORPHA:589618)
- Intellectual disability (HP:0001249): The term intellectual disability or intellectual developmental disorder is used to describe significantly sub-average intellectual and adaptive functioning based on clinical assessment and as measured by individually administered, appropriately normed, standardized and validated tests of intellectual functioning and adaptive behavior, with onset during the developmental period from infancy through adolescence. Evidence: TAS. Frequency: Frequent (HP:0040282). (ORPHA:589618)
- Dysarthria (HP:0001260): Dysarthric speech is a general description referring to a neurological speech disorder characterized by poor articulation. Depending on the involved neurological structures, dysarthria may be further classified as spastic, flaccid, ataxic, hyperkinetic and hypokinetic, or mixed. Evidence: TAS. Frequency: Frequent (HP:0040282). (ORPHA:589618)
- Dysphagia (HP:0002015): Difficulty in swallowing. Evidence: TAS. Frequency: Frequent (HP:0040282). (ORPHA:589618)
- Short stature (HP:0004322): A height below that which is expected according to age and gender norms. Although there is no universally accepted definition of short stature, many refer to "short stature" as height more than 2 standard deviations below the mean for age and gender (or below the 3rd percentile for age and gender dependent norms). Evidence: TAS. Frequency: Frequent (HP:0040282). (ORPHA:589618)
- Neurodevelopmental delay (HP:0012758): Neurodevelopmental delay (NDD) refers to delays in the maturation of the brain and central nervous system; infants and young children with NDD may experience delays in the development of one or more skills including gross motor abilities, fine-motor coordination, language abilities and ability to solve increasingly complex problems. Evidence: TAS. Frequency: Frequent (HP:0040282). (ORPHA:589618)
- Leg dystonia (HP:0031959): A type of dystonia (abnormally increased muscular tone causing fixed abnormal postures) that affects muscles of the legs. Evidence: TAS. Frequency: Frequent (HP:0040282). (ORPHA:589618)
- Long face (HP:0000276): Facial height (length) is more than 2 standard deviations above the mean (objective); or, an apparent increase in the height (length) of the face (subjective). Evidence: TAS. Frequency: Occasional (HP:0040283). (ORPHA:589618)
- Bulbous nose (HP:0000414): Increased volume and globular shape of the anteroinferior aspect of the nose. Evidence: TAS. Frequency: Occasional (HP:0040283). (ORPHA:589618)
- Nystagmus (HP:0000639): Rhythmic, involuntary oscillations of one or both eyes related to abnormality in fixation, conjugate gaze, or vestibular mechanisms. Evidence: TAS. Frequency: Occasional (HP:0040283). (ORPHA:589618)
- Depression (HP:0000716): Frequently experiencing feelings of being down, miserable, and/or hopeless; struggling to recover from these moods; having a pessimistic outlook on the future; feeling a pervasive sense of shame; having a low self-worth; experiencing thoughts of suicide and engaging in suicidal behavior. Evidence: TAS. Frequency: Occasional (HP:0040283). (ORPHA:589618)
- Autistic behavior (HP:0000729): Persistent deficits in social interaction and communication and interaction as well as a markedly restricted repertoire of activity and interest as well as repetitive patterns of behavior. Evidence: TAS. Frequency: Occasional (HP:0040283). (ORPHA:589618)
- Anxiety (HP:0000739): Intense feelings of nervousness, tension, or panic often arise in response to interpersonal stresses. There is worry about the negative effects of past unpleasant experiences and future negative possibilities. Individuals may feel fearful, apprehensive, or threatened by uncertainty, and they may also have fears of falling apart or losing control. Evidence: TAS. Frequency: Occasional (HP:0040283). (ORPHA:589618)
- Hypothyroidism (HP:0000821): Deficiency of thyroid hormone. Evidence: TAS. Frequency: Occasional (HP:0040283). (ORPHA:589618)
- Precocious puberty (HP:0000826): The onset of secondary sexual characteristics before a normal age. Although it is difficult to define normal age ranges because of the marked variation with which puberty begins in normal children, precocious puberty can be defined as the onset of puberty before the age of 8 years in girls or 9 years in boys. Evidence: TAS. Frequency: Occasional (HP:0040283). (ORPHA:589618)
- Dysphonia (HP:0001618): Difficulty in speaking due to a physical disorder of the mouth, tongue, throat, or vocal cords. Associated with a known physical or neurological cause. Evidence: TAS. Frequency: Occasional (HP:0040283). (ORPHA:589618)
- Anarthria (HP:0002425): A defect in the motor ability that enables speech. Evidence: TAS. Frequency: Occasional (HP:0040283). (ORPHA:589618)
- Clinodactyly of the 5th finger (HP:0004209): Clinodactyly refers to a bending or curvature of the fifth finger in the radial direction (i.e., towards the 4th finger). Evidence: TAS. Frequency: Occasional (HP:0040283). (ORPHA:589618)
- Attention deficit hyperactivity disorder (HP:0007018): Attention deficit hyperactivity disorder (ADHD) manifests at age 2-3 years or by first grade at the latest. The main symptoms are distractibility, impulsivity, hyperactivity, and often trouble organizing tasks and projects, difficulty going to sleep, and social problems from being aggressive, loud, or impatient. Evidence: TAS. Frequency: Occasional (HP:0040283). (ORPHA:589618)
- Abnormal pyramidal sign (HP:0007256): Functional neurological abnormalities related to dysfunction of the pyramidal tract. Evidence: TAS. Frequency: Occasional (HP:0040283). (ORPHA:589618)
- Oromandibular dystonia (HP:0012048): A kind of focal dystonia characterized by forceful contractions of the face, jaw, and/or tongue causing difficulty in opening and closing the mouth and often affecting chewing and speech. Evidence: TAS. Frequency: Occasional (HP:0040283). (ORPHA:589618)
- Arm dystonia (HP:0031960): A type of dystonia (abnormally increased muscular tone causing fixed abnormal postures) that affects muscles of the arms. Evidence: TAS. Frequency: Occasional (HP:0040283). (ORPHA:589618)
- Strabismus (HP:0000486): A misalignment of the eyes so that the visual axes deviate from bifoveal fixation. The classification of strabismus may be based on a number of features including the relative position of the eyes, whether the deviation is latent or manifest, intermittent or constant, concomitant or otherwise and according to the age of onset and the relevance of any associated refractive error. Evidence: TAS. Frequency: Very rare (HP:0040284). (ORPHA:589618)
Not associated with this disease:
- Feeding difficulties (HP:0011968): Impaired ability to eat related to problems gathering food and getting ready to suck, chew, or swallow it. Evidence: TAS. (ORPHA:589618)